Phenotypes associated with the disease infundibulopelvic stenosis-multicystic kidney syndrome (OMIM:600989):
- Microscopic hematuria (HP:0002907): Microscopic hematuria detected by dipstick or microscopic examination of the urine. Evidence: IEA. (OMIM:600989)
- Multicystic kidney dysplasia (HP:0000003): Multicystic dysplasia of the kidney is characterized by multiple cysts of varying size in the kidney and the absence of a normal pelvicaliceal system. The condition is associated with ureteral or ureteropelvic atresia, and the affected kidney is nonfunctional. Evidence: IEA. (OMIM:600989)
- Autosomal dominant inheritance (HP:0000006): A mode of inheritance that is observed for traits related to a gene encoded on one of the autosomes (i.e., the human chromosomes 1-22) in which a trait manifests in heterozygotes. In the context of medical genetics, an autosomal dominant disorder is caused when a single copy of the mutant allele is present. Males and females are affected equally, and can both transmit the disorder with a risk of 50% for each child of inheriting the mutant allele. Evidence: IEA. (OMIM:600989)
- Abdominal pain (HP:0002027): An unpleasant sensation characterized by physical discomfort (such as pricking, throbbing, or aching) and perceived to originate in the abdomen. Evidence: IEA. (OMIM:600989)